- Fever (HP:0001945): Body temperature elevated above the normal range. Evidence: TAS. Frequency: Very frequent (HP:0040281). (ORPHA:99748)
- Headache (HP:0002315): Cephalgia, or pain sensed in various parts of the head, not confined to the area of distribution of any nerve. Evidence: TAS. Frequency: Frequent (HP:0040282). (ORPHA:99748)
- Myalgia (HP:0003326): Pain in muscle. Evidence: TAS. Frequency: Very frequent (HP:0040281). (ORPHA:99748)
- Fatigue (HP:0012378): A subjective feeling of tiredness characterized by a lack of energy and motivation. Evidence: TAS. Frequency: Very frequent (HP:0040281). (ORPHA:99748)
- Cough (HP:0012735): A sudden, audible expulsion of air from the lungs through a partially closed glottis, preceded by inhalation. Evidence: TAS. Frequency: Frequent (HP:0040282). (ORPHA:99748)
These phenotypes are associated with the disease Pontiac fever (ORPHA:99748).